- Lymphedema (HP:0001004): Localized fluid retention and tissue swelling caused by a compromised lymphatic system. Evidence: PCS. (PMID:36928819)
- Autosomal dominant inheritance (HP:0000006): A mode of inheritance that is observed for traits related to a gene encoded on one of the autosomes (i.e., the human chromosomes 1-22) in which a trait manifests in heterozygotes. In the context of medical genetics, an autosomal dominant disorder is caused when a single copy of the mutant allele is present. Males and females are affected equally, and can both transmit the disorder with a risk of 50% for each child of inheriting the mutant allele. Evidence: PCS. (PMID:36928819)
These phenotypes are associated with the disease lymphatic malformation 14 (OMIM:620602).